- Gait disturbance (HP:0001288): The term gait disturbance can refer to any disruption of the ability to walk. Evidence: TAS. Frequency: Frequent (HP:0040282). (ORPHA:71519)
- Abnormal speech pattern (HP:0002167): An abnormality in the sound (volume) or cadence (rate) of speech. Evidence: TAS. Frequency: Frequent (HP:0040282). (ORPHA:71519)
- Abnormality of movement (HP:0100022): An abnormality of movement with a neurological basis characterized by changes in coordination and speed of voluntary movements. Evidence: TAS. Frequency: Very frequent (HP:0040281). (ORPHA:71519)
These phenotypes are associated with the disease Psychogenic movement disorders (ORPHA:71519).